Phenotypes associated with the disease Gingival fibromatosis-facial dysmorphism syndrome (ORPHA:2025):
- Gingival fibromatosis (HP:0000169): The presence of fibrosis of the gingiva. Evidence: TAS. Frequency: Very frequent (HP:0040281). (ORPHA:2025)
- Gingival overgrowth (HP:0000212): Hyperplasia of the gingiva (that is, a thickening of the soft tissue overlying the alveolar ridge. The degree of thickening ranges from involvement of the interdental papillae alone to gingival overgrowth covering the entire tooth crown. Evidence: TAS. Frequency: Very frequent (HP:0040281). (ORPHA:2025)
- High palate (HP:0000218): Height of the palate more than 2 SD above the mean (objective) or palatal height at the level of the first permanent molar more than twice the height of the teeth (subjective). Evidence: TAS. Frequency: Very frequent (HP:0040281). (ORPHA:2025)
- Everted lower lip vermilion (HP:0000232): An abnormal configuration of the lower lip such that it is turned outward i.e., everted, with the Inner aspect of the lower lip vermilion (normally opposing the teeth) being visible in a frontal view. Evidence: TAS. Frequency: Frequent (HP:0040282). (ORPHA:2025)
- Macrocephaly (HP:0000256): Occipitofrontal (head) circumference greater than 97th centile compared to appropriate, age matched, sex-matched normal standards. Alternatively, a apparently increased size of the cranium. Evidence: TAS. Frequency: Very frequent (HP:0040281). (ORPHA:2025)
- Hypertelorism (HP:0000316): Interpupillary distance more than 2 SD above the mean (alternatively, the appearance of an increased interpupillary distance or widely spaced eyes). Evidence: TAS. Frequency: Very frequent (HP:0040281). (ORPHA:2025)
- Underdeveloped nasal alae (HP:0000430): Thinned, deficient, or excessively arched ala nasi. Evidence: TAS. Frequency: Very frequent (HP:0040281). (ORPHA:2025)
- Downslanted palpebral fissures (HP:0000494): The palpebral fissure inclination is more than two standard deviations below the mean. Evidence: TAS. Frequency: Very frequent (HP:0040281). (ORPHA:2025)
- Thick eyebrow (HP:0000574): Increased density/number and/or increased diameter of eyebrow hairs. Evidence: TAS. Frequency: Very frequent (HP:0040281). (ORPHA:2025)
- Synophrys (HP:0000664): Meeting of the medial eyebrows in the midline. Evidence: TAS. Frequency: Very frequent (HP:0040281). (ORPHA:2025)
- Delayed eruption of teeth (HP:0000684): Delayed tooth eruption, which can be defined as tooth eruption more than 2 SD beyond the mean eruption age. Evidence: TAS. Frequency: Very frequent (HP:0040281). (ORPHA:2025)
- Exaggerated cupid's bow (HP:0002263): More pronounced paramedian peaks and median notch of the Cupid's bow. Evidence: TAS. Frequency: Frequent (HP:0040282). (ORPHA:2025)
- Depressed nasal bridge (HP:0005280): Posterior positioning of the nasal root in relation to the overall facial profile for age. Evidence: TAS. Frequency: Very frequent (HP:0040281). (ORPHA:2025)
- Abnormal dental morphology (HP:0006482): An abnormality of the morphology of the tooth. Evidence: TAS. Frequency: Very frequent (HP:0040281). (ORPHA:2025)